- Juvenile onset (HP:0003621): Onset of signs or symptoms of disease between the age of 5 and 15 years. Evidence: PCS. Frequency: 2/2. (PMID:29231814)
- Secondary amenorrhea (HP:0000869). Evidence: PCS. Frequency: 1/2. (PMID:29231814)
- Irregular menstruation (HP:0000858): Abnormally high variation in the amount of time between periods. Evidence: PCS. Frequency: 2/2. (PMID:29231814)
- Elevated circulating follicle stimulating hormone level (HP:0008232): An elevated concentration of follicle-stimulating hormone in the blood. Evidence: PCS. Frequency: 2/2. (PMID:29231814)
- Oligomenorrhea (HP:0000876): Infrequent menses (less than 6 per year or more than 35 days between cycles). Evidence: PCS. Frequency: 1/2. (PMID:29231814)
- Autosomal recessive inheritance (HP:0000007): A mode of inheritance that is observed for traits related to a gene encoded on one of the autosomes (i.e., the human chromosomes 1-22) in which a trait manifests in individuals with two pathogenic alleles, either homozygotes (two copies of the same mutant allele) or compound heterozygotes (whereby each copy of a gene has a distinct mutant allele). Evidence: PCS. (PMID:29231814)
- Decreased circulating antimullerian hormone circulation (HP:0031103): A reduction below the normal range of the antimullerian hormone in the circulation. Evidence: PCS. Frequency: 2/2. (PMID:29231814)
These phenotypes are associated with the disease premature ovarian failure 15 (OMIM:618096).